- Posteriorly rotated ears (HP:0000358): A type of abnormal location of the ears in which the position of the ears is characterized by posterior rotation (the superior part of the ears is rotated towards the back of the head, and the inferior part of the ears towards the front). Evidence: TAS. Frequency: Occasional (HP:0040283). (ORPHA:1713)
- Abnormality of the pharynx (HP:0000600): An anomaly of the pharynx, i.e., of the tubular structure extending from the base of the skull superiorly to the esophageal inlet inferiorly. Evidence: TAS. Frequency: Very frequent (HP:0040281). (ORPHA:1713)
- Autism (HP:0000717): Autism is a neurodevelopmental disorder characterized by impaired social interaction and communication, and by restricted and repetitive behavior. Autism begins in childhood. It is marked by the presence of markedly abnormal or impaired development in social interaction and communication and a markedly restricted repertoire of activity and interest. Manifestations of the disorder vary greatly depending on the developmental level and chronological age of the individual (DSM-IV). Evidence: TAS. Frequency: Very frequent (HP:0040281). (ORPHA:1713)
- Hypotonia (HP:0001252): Hypotonia is an abnormally low muscle tone (the amount of tension or resistance to movement in a muscle). Even when relaxed, muscles have a continuous and passive partial contraction which provides some resistance to passive stretching. Hypotonia thus manifests as diminished resistance to passive stretching. Hypotonia is not the same as muscle weakness, although the two conditions can co-exist. Evidence: TAS. Frequency: Very frequent (HP:0040281). (ORPHA:1713)
- Mild intellectual disability (HP:0001256): Mild intellectual disability (ID) is defined as a type of ID characterized by mildly sub-average adaptive functioning and intellectual functioning, with an intelligence quotient (IQ) the range of 50-69. Evidence: TAS. Frequency: Very frequent (HP:0040281). (ORPHA:1713)
- Dysarthria (HP:0001260): Dysarthric speech is a general description referring to a neurological speech disorder characterized by poor articulation. Depending on the involved neurological structures, dysarthria may be further classified as spastic, flaccid, ataxic, hyperkinetic and hypokinetic, or mixed. Evidence: TAS. Frequency: Very frequent (HP:0040281). (ORPHA:1713)
- Global developmental delay (HP:0001263): A delay in the achievement of motor or mental milestones in the domains of development of a child, including motor skills, speech and language, cognitive skills, and social and emotional skills. This term should only be used to describe children younger than five years of age. Evidence: TAS. Frequency: Very frequent (HP:0040281). (ORPHA:1713)
- Failure to thrive (HP:0001508): Failure to thrive (FTT) refers to a child whose physical growth is substantially below the norm. Evidence: TAS. Frequency: Very frequent (HP:0040281). (ORPHA:1713)
- Aphasia (HP:0002381): An acquired language impairment of some or all of the abilities to produce or comprehend speech and to read or write. Evidence: TAS. Frequency: Very frequent (HP:0040281). (ORPHA:1713)
- Expressive language delay (HP:0002474): A delay in the acquisition of the ability to use language to communicate needs, wishes, or thoughts. Evidence: TAS. Frequency: Very frequent (HP:0040281). (ORPHA:1713)
- Abnormality of chromosome segregation (HP:0002916): An abnormality of chromosome segregation. Evidence: TAS. Frequency: Very frequent (HP:0040281). (ORPHA:1713)
- Attention deficit hyperactivity disorder (HP:0007018): Attention deficit hyperactivity disorder (ADHD) manifests at age 2-3 years or by first grade at the latest. The main symptoms are distractibility, impulsivity, hyperactivity, and often trouble organizing tasks and projects, difficulty going to sleep, and social problems from being aggressive, loud, or impatient. Evidence: TAS. Frequency: Very frequent (HP:0040281). (ORPHA:1713)
- Echolalia (HP:0010529): Echolalia is the automatic imitative repetition of sounds, words, or phrases in the absence of explicit awareness. The repeated words or phrases are typically odd or used in a non-social manner. These can be words or phrases that the affected individual has heard or invented. Evidence: TAS. Frequency: Very frequent (HP:0040281). (ORPHA:1713)
- Sleep apnea (HP:0010535): An intermittent cessation of airflow at the mouth and nose during sleep is known as sleep apnea. Apneas that last at least 10 seconds are considered significant, but individuals with sleep apnea may experience apneas lasting from 20 seconds up to 2 or 3 minutes. Patients may have up to 15 events per hour of sleep. Evidence: TAS. Frequency: Very frequent (HP:0040281). (ORPHA:1713)
- Triangular face (HP:0000325): Facial contour, as viewed from the front, triangular in shape, with breadth at the temples and tapering to a narrow chin. Evidence: TAS. Frequency: Frequent (HP:0040282). (ORPHA:1713)
- Broad forehead (HP:0000337): Width of the forehead or distance between the frontotemporales is more than two standard deviations above the mean (objective); or apparently increased distance between the two sides of the forehead. Evidence: TAS. Frequency: Frequent (HP:0040282). (ORPHA:1713)
- Micrognathia (HP:0000347): Developmental hypoplasia of the mandible. Evidence: TAS. Frequency: Frequent (HP:0040282). (ORPHA:1713)
- Downslanted palpebral fissures (HP:0000494): The palpebral fissure inclination is more than two standard deviations below the mean. Evidence: TAS. Frequency: Frequent (HP:0040282). (ORPHA:1713)
- Anxiety (HP:0000739): Intense feelings of nervousness, tension, or panic often arise in response to interpersonal stresses. There is worry about the negative effects of past unpleasant experiences and future negative possibilities. Individuals may feel fearful, apprehensive, or threatened by uncertainty, and they may also have fears of falling apart or losing control. Evidence: TAS. Frequency: Frequent (HP:0040282). (ORPHA:1713)
- Gastroesophageal reflux (HP:0002020): A condition in which the stomach contents leak backwards from the stomach into the esophagus through the lower esophageal sphincter. Evidence: TAS. Frequency: Frequent (HP:0040282). (ORPHA:1713)
- EEG abnormality (HP:0002353): Abnormality observed by electroencephalogram (EEG), which is used to record of the brain's spontaneous electrical activity from multiple electrodes placed on the scalp. Evidence: TAS. Frequency: Frequent (HP:0040282). (ORPHA:1713)
- Scoliosis (HP:0002650): The presence of an abnormal lateral curvature of the spine. Evidence: TAS. Frequency: Frequent (HP:0040282). (ORPHA:1713)
- Poor fine motor coordination (HP:0007010): An abnormality of the ability (skills) to perform a precise movement of small muscles with the intent to perform a specific act. Fine motor skills are required to mediate movements of the wrists, hands, fingers, feet, and toes. Evidence: TAS. Frequency: Frequent (HP:0040282). (ORPHA:1713)
- High hypermetropia (HP:0008499): A severe form of hypermetropia with over +5.00 diopters. Evidence: TAS. Frequency: Frequent (HP:0040282). (ORPHA:1713)
- Speech apraxia (HP:0011098): A type of apraxia that is characterized by difficulty or inability to execute speech movements because of problems with coordination and motor problems, leading to incorrect articulation. An increase of errors with increasing word and phrase length may occur. Evidence: TAS. Frequency: Frequent (HP:0040282). (ORPHA:1713)
- Abnormal cardiovascular system morphology (HP:0030680): Any structural anomaly of the heart and blood vessels. Evidence: TAS. Frequency: Frequent (HP:0040282). (ORPHA:1713)
- Oral-pharyngeal dysphagia (HP:0200136). Evidence: TAS. Frequency: Frequent (HP:0040282). (ORPHA:1713)
- Wide mouth (HP:0000154): Distance between the oral commissures more than 2 SD above the mean. Alternatively, an apparently increased width of the oral aperture (subjective). Evidence: TAS. Frequency: Occasional (HP:0040283). (ORPHA:1713)
- Microcephaly (HP:0000252): Head circumference below 2 standard deviations below the mean for age and gender. Evidence: TAS. Frequency: Occasional (HP:0040283). (ORPHA:1713)
- Hypertelorism (HP:0000316): Interpupillary distance more than 2 SD above the mean (alternatively, the appearance of an increased interpupillary distance or widely spaced eyes). Evidence: TAS. Frequency: Occasional (HP:0040283). (ORPHA:1713)
- Hearing impairment (HP:0000365): A decreased magnitude of the sensory perception of sound. Evidence: TAS. Frequency: Occasional (HP:0040283). (ORPHA:1713)
- Hypoplasia of the corpus callosum (HP:0002079): Underdevelopment of the corpus callosum. Evidence: TAS. Frequency: Occasional (HP:0040283). (ORPHA:1713)
- Short stature (HP:0004322): A height below that which is expected according to age and gender norms. Although there is no universally accepted definition of short stature, many refer to "short stature" as height more than 2 standard deviations below the mean for age and gender (or below the 3rd percentile for age and gender dependent norms). Evidence: TAS. Frequency: Occasional (HP:0040283). (ORPHA:1713)
- Abnormal dental morphology (HP:0006482): An abnormality of the morphology of the tooth. Evidence: TAS. Frequency: Occasional (HP:0040283). (ORPHA:1713)
- Open bite (HP:0010807): Visible space between the dental arches in occlusion. Evidence: TAS. Frequency: Occasional (HP:0040283). (ORPHA:1713)
These phenotypes are associated with the disease 17p11.2 microduplication syndrome (ORPHA:1713).